- Abnormal circulating follicle-stimulating hormone concentration (HP:0030346): An anomaly of the circulating level of follicle-stimulating hormone (FSH). Evidence: PCS. Frequency: 0/3. (PMID:35534203)
- Abnormal circulating luteinizing hormone concentration (HP:0030345): An anomaly of the circulating level of luteinizing hormone (LH). Evidence: PCS. Frequency: 0/3. (PMID:35534203)
- Reduced progressive sperm motility (HP:0034011): A reduced proportion of sperm that move in a straight line or large circles; alternatively, an increased proportion of sperm that move in tight circles or in some other non-linear fashion. Evidence: PCS. Frequency: 3/3. (PMID:35534203)
- Male infertility (HP:0003251). Evidence: PCS. Frequency: 3/3. (PMID:35534203)
- Young adult onset (HP:0011462): Onset of disease at the age of between 16 and 40 years. Evidence: PCS. Frequency: 3/3. (PMID:35534203)
- Autosomal recessive inheritance (HP:0000007): A mode of inheritance that is observed for traits related to a gene encoded on one of the autosomes (i.e., the human chromosomes 1-22) in which a trait manifests in individuals with two pathogenic alleles, either homozygotes (two copies of the same mutant allele) or compound heterozygotes (whereby each copy of a gene has a distinct mutant allele). Evidence: PCS. (PMID:35534203)
- Oligozoospermia (HP:0000798): Reduced count of spermatozoa in the semen, defined as a sperm count below 20 million per milliliter semen. Evidence: PCS. Frequency: 0/3. (PMID:35534203)
These phenotypes are associated with the disease spermatogenic failure 90 (OMIM:620744).